- Cough (HP:0012735): A sudden, audible expulsion of air from the lungs through a partially closed glottis, preceded by inhalation. Evidence: TAS. Frequency: Very frequent (HP:0040281). (ORPHA:140896)
- Fever (HP:0001945): Body temperature elevated above the normal range. Evidence: TAS. Frequency: Frequent (HP:0040282). (ORPHA:140896)
- Dyspnea (HP:0002094): Difficult or labored breathing. Dyspnea is a subjective feeling only the patient can rate, e.g., on a Borg scale. Evidence: TAS. Frequency: Frequent (HP:0040282). (ORPHA:140896)
- Respiratory distress (HP:0002098): Respiratory distress is objectively observable as the physical or emotional consequences from the experience of dyspnea. The physical presentation of respiratory distress is generally referred to as labored breathing, while the sensation of respiratory distress is called shortness of breath or dyspnea. Evidence: TAS. Frequency: Frequent (HP:0040282). (ORPHA:140896)
- Headache (HP:0002315): Cephalgia, or pain sensed in various parts of the head, not confined to the area of distribution of any nerve. Evidence: TAS. Frequency: Frequent (HP:0040282). (ORPHA:140896)
- Immunodeficiency (HP:0002721): Failure of the immune system to protect the body adequately from infection, due to the absence or insufficiency of some component process or substance. Evidence: TAS. Frequency: Frequent (HP:0040282). (ORPHA:140896)
- Myalgia (HP:0003326): Pain in muscle. Evidence: TAS. Frequency: Frequent (HP:0040282). (ORPHA:140896)
- Diabetes mellitus (HP:0000819): A group of abnormalities characterized by hyperglycemia and glucose intolerance. Evidence: TAS. Frequency: Occasional (HP:0040283). (ORPHA:140896)
- Abnormality of the cardiovascular system (HP:0001626): Any abnormality of the cardiovascular system. Evidence: TAS. Frequency: Occasional (HP:0040283). (ORPHA:140896)
- Neoplasm (HP:0002664): An organ or organ-system abnormality that consists of uncontrolled autonomous cell-proliferation which can occur in any part of the body as a benign or malignant neoplasm (tumor). Evidence: TAS. Frequency: Occasional (HP:0040283). (ORPHA:140896)
- Respiratory failure requiring assisted ventilation (HP:0004887): A state of respiratory distress that requires a life saving intervention in the form of gaining airway access and instituting positive pressure ventilation. Evidence: TAS. Frequency: Occasional (HP:0040283). (ORPHA:140896)
- Chronic lung disease (HP:0006528): According to the definitions of the American and British Thoracic Societies, including pulmonary functional tests, X-rays, and CT scans for items such as fibrosis, bronchiectasis, bullae, emphysema, nodular or lymphomatous abnormalities. Evidence: TAS. Frequency: Occasional (HP:0040283). (ORPHA:140896)
- Acute infectious pneumonia (HP:0011949): Acute inflammation of the lung due to an infection. Evidence: TAS. Frequency: Occasional (HP:0040283). (ORPHA:140896)
- Hypoxemia (HP:0012418): An abnormally low level of blood oxygen. Evidence: TAS. Frequency: Occasional (HP:0040283). (ORPHA:140896)
- Pharyngitis (HP:0025439): Inflammation (due to infection or irritation) of the pharynx. Evidence: TAS. Frequency: Occasional (HP:0040283). (ORPHA:140896)
- Acute kidney injury (HP:0001919): Sudden loss of renal function, as manifested by decreased urine production, and a rise in serum creatinine or blood urea nitrogen concentration (azotemia). Evidence: TAS. Frequency: Very rare (HP:0040284). (ORPHA:140896)
These phenotypes are associated with the disease Severe acute respiratory syndrome (ORPHA:140896).